Phenotypes associated with the disease familial chronic myelocytic leukemia-like syndrome (OMIM:600080):
- Chronic myelogenous leukemia (HP:0005506): A myeloproliferative disorder characterized by increased proliferation of the granulocytic cell line without the loss of their capacity to differentiate. Evidence: TAS. (OMIM:600080)
- Autosomal dominant inheritance (HP:0000006): A mode of inheritance that is observed for traits related to a gene encoded on one of the autosomes (i.e., the human chromosomes 1-22) in which a trait manifests in heterozygotes. In the context of medical genetics, an autosomal dominant disorder is caused when a single copy of the mutant allele is present. Males and females are affected equally, and can both transmit the disorder with a risk of 50% for each child of inheriting the mutant allele. Evidence: TAS. (OMIM:600080)